- Pierre-Robin sequence (HP:0000201): Pierre Robin malformation is a sequence of developmental malformations characterized by micrognathia (mandibular hypoplasia), glossoptosis and cleft palate. Evidence: TAS. Frequency: Very frequent (HP:0040281). (ORPHA:2886)
- Atrial septal defect (HP:0001631): Atrial septal defect (ASD) is a congenital abnormality of the interatrial septum that enables blood flow between the left and right atria via the interatrial septum. Evidence: TAS. Frequency: Very frequent (HP:0040281). (ORPHA:2886)
- Talipes equinovarus (HP:0001762): Talipes equinovarus (also called clubfoot) typically has four main components: inversion and adduction of the forefoot; inversion of the heel and hindfoot; equinus (limitation of extension) of the ankle and subtalar joint; and internal rotation of the leg. Evidence: TAS. Frequency: Very frequent (HP:0040281). (ORPHA:2886)
- Persistent left superior vena cava (HP:0005301): A rare congenital vascular anomaly that results when the left superior cardinal vein caudal to the innominate vein fails to regress. Evidence: TAS. Frequency: Very frequent (HP:0040281). (ORPHA:2886)
- Glossoptosis (HP:0000162): Posterior displacement of the tongue into the pharynx, i.e., a tongue that is mislocalised posteriorly. Evidence: TAS. Frequency: Frequent (HP:0040282). (ORPHA:2886)
- Cleft palate (HP:0000175): Cleft palate is a developmental defect of the palate resulting from a failure of fusion of the palatine processes and manifesting as a separation of the roof of the mouth (soft and hard palate). Evidence: TAS. Frequency: Frequent (HP:0040282). (ORPHA:2886)
- Hypertelorism (HP:0000316): Interpupillary distance more than 2 SD above the mean (alternatively, the appearance of an increased interpupillary distance or widely spaced eyes). Evidence: TAS. Frequency: Frequent (HP:0040282). (ORPHA:2886)
- Sloping forehead (HP:0000340): Inclination of the anterior surface of the forehead from the vertical more than two standard deviations above the mean (objective); or apparently excessive posterior sloping of the forehead in a lateral view. Evidence: TAS. Frequency: Frequent (HP:0040282). (ORPHA:2886)
- Micrognathia (HP:0000347): Developmental hypoplasia of the mandible. Evidence: TAS. Frequency: Frequent (HP:0040282). (ORPHA:2886)
- Wide nasal bridge (HP:0000431): Increased breadth of the nasal bridge (and with it, the nasal root). Evidence: TAS. Frequency: Frequent (HP:0040282). (ORPHA:2886)
- Cyanosis (HP:0000961): Bluish discoloration of the skin and mucosa due to poor circulation or inadequate oxygenation of arterial or capillary blood. Evidence: TAS. Frequency: Frequent (HP:0040282). (ORPHA:2886)
- Intellectual disability (HP:0001249): The term intellectual disability or intellectual developmental disorder is used to describe significantly sub-average intellectual and adaptive functioning based on clinical assessment and as measured by individually administered, appropriately normed, standardized and validated tests of intellectual functioning and adaptive behavior, with onset during the developmental period from infancy through adolescence. Evidence: TAS. Frequency: Frequent (HP:0040282). (ORPHA:2886)
- Global developmental delay (HP:0001263): A delay in the achievement of motor or mental milestones in the domains of development of a child, including motor skills, speech and language, cognitive skills, and social and emotional skills. This term should only be used to describe children younger than five years of age. Evidence: TAS. Frequency: Frequent (HP:0040282). (ORPHA:2886)
- Generalized hypotonia (HP:0001290): Generalized muscular hypotonia (abnormally low muscle tone). Evidence: TAS. Frequency: Frequent (HP:0040282). (ORPHA:2886)
- Failure to thrive (HP:0001508): Failure to thrive (FTT) refers to a child whose physical growth is substantially below the norm. Evidence: TAS. Frequency: Frequent (HP:0040282). (ORPHA:2886)
- Intrauterine growth retardation (HP:0001511): An abnormal restriction of fetal growth with fetal weight below the tenth percentile for gestational age. Evidence: TAS. Frequency: Frequent (HP:0040282). (ORPHA:2886)
- Rocker bottom foot (HP:0001838): The presence of both a prominent heel and a convex contour of the sole. Evidence: TAS. Frequency: Frequent (HP:0040282). (ORPHA:2886)
- Underdeveloped supraorbital ridges (HP:0009891): Flatness of the supraorbital portion of the frontal bones. Evidence: TAS. Frequency: Frequent (HP:0040282). (ORPHA:2886)
- Cryptorchidism (HP:0000028): Testis in inguinal canal. That is, absence of one or both testes from the scrotum owing to failure of the testis or testes to descend through the inguinal canal to the scrotum. Evidence: TAS. Frequency: Occasional (HP:0040283). (ORPHA:2886)
- Horseshoe kidney (HP:0000085): A connection of the right and left kidney by an isthmus of functioning renal parenchyma or fibrous tissue that crosses the midline. Evidence: TAS. Frequency: Occasional (HP:0040283). (ORPHA:2886)
- Hydronephrosis (HP:0000126): Severe distention of the kidney with dilation of the renal pelvis and calices. Evidence: TAS. Frequency: Occasional (HP:0040283). (ORPHA:2886)
- Large fontanelles (HP:0000239): In newborns, the two frontal bones, two parietal bones, and one occipital bone are joined by fibrous sutures, which form a small posterior fontanelle, and a larger, diamond-shaped anterior fontanelle. These regions allow for the skull to pass the birth canal and for later growth. The fontanelles gradually ossify, whereby the posterior fontanelle usually closes by eight weeks and the anterior fontanelle by the 9th to 16th month of age. Large fontanelles are diagnosed if the fontanelles are larger than age-dependent norms. Evidence: TAS. Frequency: Occasional (HP:0040283). (ORPHA:2886)
- Hearing impairment (HP:0000365): A decreased magnitude of the sensory perception of sound. Evidence: TAS. Frequency: Occasional (HP:0040283). (ORPHA:2886)
- Small earlobe (HP:0000385): Reduced volume of the earlobe. Evidence: TAS. Frequency: Occasional (HP:0040283). (ORPHA:2886)
- Prominent antihelix (HP:0000395): The presence of an abnormally prominent antihelix. Evidence: TAS. Frequency: Occasional (HP:0040283). (ORPHA:2886)
- Anteverted nares (HP:0000463): Anteriorly-facing nostrils viewed with the head in the Frankfurt horizontal and the eyes of the observer level with the eyes of the subject. This gives the appearance of an upturned nose (upturned nasal tip). Evidence: TAS. Frequency: Occasional (HP:0040283). (ORPHA:2886)
- Myopia (HP:0000545): An abnormality of refraction characterized by the ability to see objects nearby clearly, while objects in the distance appear blurry. Evidence: TAS. Frequency: Occasional (HP:0040283). (ORPHA:2886)
- Thick eyebrow (HP:0000574): Increased density/number and/or increased diameter of eyebrow hairs. Evidence: TAS. Frequency: Occasional (HP:0040283). (ORPHA:2886)
- Single transverse palmar crease (HP:0000954): The distal and proximal transverse palmar creases are merged into a single transverse palmar crease. Evidence: TAS. Frequency: Occasional (HP:0040283). (ORPHA:2886)
- Hand polydactyly (HP:0001161): A kind of polydactyly characterized by the presence of a supernumerary finger or fingers. Evidence: TAS. Frequency: Occasional (HP:0040283). (ORPHA:2886)
- Seizure (HP:0001250): A seizure is an intermittent abnormality of nervous system physiology characterized by a transient occurrence of signs and/or symptoms due to abnormal excessive or synchronous neuronal activity in the brain. Evidence: TAS. Frequency: Occasional (HP:0040283). (ORPHA:2886)
- Abnormal corpus callosum morphology (HP:0001273): Abnormality of the corpus callosum. Evidence: TAS. Frequency: Occasional (HP:0040283). (ORPHA:2886)
- Cerebellar hypoplasia (HP:0001321): Cerebellar hypoplasia is a descriptive term implying a cerebellum with a reduced volume, but a normal shape and is stable over time. Evidence: TAS. Frequency: Occasional (HP:0040283). (ORPHA:2886)
- Extramedullary hematopoiesis (HP:0001978): The process of hematopoiesis occurring outside of the bone marrow (in the liver, thymus, and spleen) in the postnatal organisms. Evidence: TAS. Frequency: Occasional (HP:0040283). (ORPHA:2886)
- Apnea (HP:0002104): Lack of breathing with no movement of the respiratory muscles and no exchange of air in the lungs. This term refers to a disposition to have recurrent episodes of apnea rather than to a single event. Evidence: TAS. Frequency: Occasional (HP:0040283). (ORPHA:2886)
- Broad-based gait (HP:0002136): An abnormal gait pattern in which persons stand and walk with their feet spaced widely apart. This is often a component of cerebellar ataxia. Evidence: TAS. Frequency: Occasional (HP:0040283). (ORPHA:2886)
- Scoliosis (HP:0002650): The presence of an abnormal lateral curvature of the spine. Evidence: TAS. Frequency: Occasional (HP:0040283). (ORPHA:2886)
- Widely patent fontanelles and sutures (HP:0004492): An abnormally increased width of the cranial fontanelles and sutures. Evidence: TAS. Frequency: Occasional (HP:0040283). (ORPHA:2886)
- Finger syndactyly (HP:0006101): Webbing or fusion of the fingers, involving soft parts only or including bone structure. Bony fusions are referred to as "bony" Syndactyly if the fusion occurs in a radio-ulnar axis. Fusions of bones of the fingers in a proximo-distal axis are referred to as "Symphalangism". Evidence: TAS. Frequency: Occasional (HP:0040283). (ORPHA:2886)
- Hypoplasia of proximal radius (HP:0006434): Proximal radial shortening owing to a congenital defect of development. Evidence: TAS. Frequency: Occasional (HP:0040283). (ORPHA:2886)
- Abnormal antihelix morphology (HP:0009738): An abnormality of the antihelix. Evidence: TAS. Frequency: Occasional (HP:0040283). (ORPHA:2886)
- Short palpebral fissure (HP:0012745): Distance between the medial and lateral canthi is more than 2 SD below the mean for age (objective); or, apparently reduced length of the palpebral fissures. Evidence: TAS. Frequency: Occasional (HP:0040283). (ORPHA:2886)
- Clinodactyly (HP:0030084): An angulation of a digit at an interphalangeal joint in the plane of the palm (finger) or sole (toe). Evidence: TAS. Frequency: Occasional (HP:0040283). (ORPHA:2886)
- Tongue nodules (HP:0000199). Evidence: TAS. Frequency: Very rare (HP:0040284). (ORPHA:2886)
- Optic atrophy (HP:0000648): Atrophy of the optic nerve. Optic atrophy results from the death of the retinal ganglion cell axons that comprise the optic nerve and manifesting as a pale optic nerve on fundoscopy. Evidence: TAS. Frequency: Very rare (HP:0040284). (ORPHA:2886)
- Pectus excavatum (HP:0000767): A defect of the chest wall characterized by a depression of the sternum, giving the chest ("pectus") a caved-in ("excavatum") appearance. Evidence: TAS. Frequency: Very rare (HP:0040284). (ORPHA:2886)
- Short sternum (HP:0000879): Decreased inferosuperior length of the sternum. Evidence: TAS. Frequency: Very rare (HP:0040284). (ORPHA:2886)
- Tetralogy of Fallot (HP:0001636): A congenital cardiac malformation comprising pulmonary stenosis, overriding aorta, ventricular septum defect, and right ventricular hypertrophy. The diagnosis of TOF is made if at least three of the four above mentioned features are present. Evidence: TAS. Frequency: Very rare (HP:0040284). (ORPHA:2886)
- Pulmonary hypoplasia (HP:0002089). Evidence: TAS. Frequency: Very rare (HP:0040284). (ORPHA:2886)
- Abnormal duodenum morphology (HP:0002246): An abnormality of the duodenum, i.e., the first section of the small intestine. Evidence: TAS. Frequency: Very rare (HP:0040284). (ORPHA:2886)
- Alveolar ridge overgrowth (HP:0009085): Increased width of the alveolar ridges. Evidence: TAS. Frequency: Very rare (HP:0040284). (ORPHA:2886)
- Abnormal hair pattern (HP:0010720): An abnormality of the distribution of hair growth. Evidence: TAS. Frequency: Very rare (HP:0040284). (ORPHA:2886)
- Athetoid cerebral palsy (HP:0011445): A type of cerebral palsy characterized by slow, involuntary muscle movement and mixed muscle tone. Evidence: TAS. Frequency: Very rare (HP:0040284). (ORPHA:2886)
- Postaxial polydactyly (HP:0100259): A form of polydactyly in which the extra digit or digits are localized on the side of the fifth finger or fifth toe. Evidence: TAS. Frequency: Very rare (HP:0040284). (ORPHA:2886)
- Posteriorly rotated ears (HP:0000358): A type of abnormal location of the ears in which the position of the ears is characterized by posterior rotation (the superior part of the ears is rotated towards the back of the head, and the inferior part of the ears towards the front). Evidence: TAS. Frequency: Occasional (HP:0040283). (ORPHA:2886)
These phenotypes are associated with the disease TARP syndrome (ORPHA:2886).